- Congenital curved nail of fourth toe (HP:0008393). Evidence: IEA. (OMIM:219070)
- Short distal phalanx of finger (HP:0009882): Short distance from the end of the finger to the most distal interphalangeal crease or the distal interphalangeal joint flexion point. That is, hypoplasia of one or more of the distal phalanx of finger. Evidence: IEA. (OMIM:219070)
- Hyperconvex fingernails (HP:0001812): When viewed on end (with the finger tip pointing toward the examiner's eye) the curve of the fingernail forms a tighter curve of convexity. Evidence: IEA. (OMIM:219070)
- Autosomal recessive inheritance (HP:0000007): A mode of inheritance that is observed for traits related to a gene encoded on one of the autosomes (i.e., the human chromosomes 1-22) in which a trait manifests in individuals with two pathogenic alleles, either homozygotes (two copies of the same mutant allele) or compound heterozygotes (whereby each copy of a gene has a distinct mutant allele). Evidence: IEA. (OMIM:219070)
These phenotypes are associated with the disease curved nail of fourth toe (OMIM:219070).